- Abnormality of the hand (HP:0001155, a Human Phenotype Ontology term): An abnormality affecting one or both hands. Evidence: IEA. (OMIM:129500)
- Abnormality of the dentition (HP:0000164, a Human Phenotype Ontology term): Any abnormality of the teeth. Evidence: IEA. (OMIM:129500)
- Small nail (HP:0001792, a Human Phenotype Ontology term): A nail that is diminished in length and width, i.e., underdeveloped nail. Evidence: IEA. (OMIM:129500)
- Alopecia totalis (HP:0007418, a Human Phenotype Ontology term): Loss of all scalp hair. Evidence: TAS. (OMIM:129500)
- Strabismus (HP:0000486, a Human Phenotype Ontology term): A misalignment of the eyes so that the visual axes deviate from bifoveal fixation. The classification of strabismus may be based on a number of features including the relative position of the eyes, whether the deviation is latent or manifest, intermittent or constant, concomitant or otherwise and according to the age of onset and the relevance of any associated refractive error. Evidence: IEA. (OMIM:129500)
- Absent axillary hair (HP:0002221, a Human Phenotype Ontology term): Absence of axillary hair. Evidence: PCS. (OMIM:129500)
- Short stature (HP:0004322, a Human Phenotype Ontology term): A height below that which is expected according to age and gender norms. Although there is no universally accepted definition of short stature, many refer to "short stature" as height more than 2 standard deviations below the mean for age and gender (or below the 3rd percentile for age and gender dependent norms). Evidence: PCS. (OMIM:129500)
- Alopecia (HP:0001596, a Human Phenotype Ontology term): A noncongenital process of hair loss, which may progress to partial or complete baldness. Evidence: TAS. (OMIM:129500)
- Nail dysplasia (HP:0002164, a Human Phenotype Ontology term): The presence of developmental dysplasia of the nail. Evidence: PCS. (OMIM:129500)
- Sparse eyebrow (HP:0045075, a Human Phenotype Ontology term): Decreased density/number of eyebrow hairs. Evidence: TAS. (OMIM:129500)
- Cataract (HP:0000518, a Human Phenotype Ontology term): A cataract is an opacity or clouding that develops in the crystalline lens of the eye or in its capsule. Evidence: IEA. (OMIM:129500)
- Variable expressivity (HP:0003828, a Human Phenotype Ontology term): A variable severity of phenotypic features. Evidence: TAS. (OMIM:129500)
- Onycholysis (HP:0001806, a Human Phenotype Ontology term): Detachment of the nail from the nail bed. Evidence: IEA. (OMIM:129500)
- Photophobia (HP:0000613, a Human Phenotype Ontology term): Excessive sensitivity to light with the sensation of discomfort or pain in the eyes due to exposure to bright light. Evidence: IEA. (OMIM:129500)
- Hyperpigmentation of the skin (HP:0000953, a Human Phenotype Ontology term): A darkening of the skin related to an increase in melanin production and deposition. Evidence: IEA. (OMIM:129500)
- Sparse eyelashes (HP:0000653, a Human Phenotype Ontology term): Decreased density/number of eyelashes. Evidence: IEA. (OMIM:129500)
- Palmoplantar hyperkeratosis (HP:0000972, a Human Phenotype Ontology term): Abnormal thickening of the skin localized to the palm of the hand and the sole of the foot. Evidence: IEA. (OMIM:129500)
- Blepharitis (HP:0000498, a Human Phenotype Ontology term): Inflammation of the eyelids. Evidence: IEA. (OMIM:129500)
- Slow-growing hair (HP:0002217, a Human Phenotype Ontology term): Hair whose growth is slower than normal. Evidence: PCS. (OMIM:129500)
- Absent pubic hair (HP:0002555, a Human Phenotype Ontology term): Absence of pubic hair. Evidence: PCS. (OMIM:129500)
- Abnormal foot morphology (HP:0001760, a Human Phenotype Ontology term): An abnormality of the skeleton of foot. Evidence: IEA. (OMIM:129500)
- Fine hair (HP:0002213, a Human Phenotype Ontology term): Hair that is fine or thin to the touch. Evidence: PCS. (OMIM:129500)
- Brittle hair (HP:0002299, a Human Phenotype Ontology term): Fragile, easily breakable hair, i.e., with reduced tensile strength. Evidence: PCS. (OMIM:129500)
- Ectodermal dysplasia (HP:0000968, a Human Phenotype Ontology term): Ectodermal dysplasia is a group of conditions in which there is abnormal development of the skin, hair, nails, teeth, or sweat glands. Evidence: IEA. (OMIM:129500)
- Conjunctivitis (HP:0000509, a Human Phenotype Ontology term): Inflammation of the conjunctiva. Evidence: IEA. (OMIM:129500)
- Nail dystrophy (HP:0008404, a Human Phenotype Ontology term): Onychodystrophy (nail dystrophy) refers to nail changes apart from changes of the color (nail dyschromia) and involves partial or complete disruption of the various keratinous layers of the nail plate. Evidence: TAS. (OMIM:129500)
- Autosomal dominant inheritance (HP:0000006, a Human Phenotype Ontology term): A mode of inheritance that is observed for traits related to a gene encoded on one of the autosomes (i.e., the human chromosomes 1-22) in which a trait manifests in heterozygotes. In the context of medical genetics, an autosomal dominant disorder is caused when a single copy of the mutant allele is present. Males and females are affected equally, and can both transmit the disorder with a risk of 50% for each child of inheriting the mutant allele. Evidence: PCS. (PMID:11017065)
These phenotypes are associated with the disease Clouston syndrome (OMIM:129500, an entry in Online Mendelian Inheritance in Man).